Phenotypes associated with the disease scalp defects-postaxial polydactyly syndrome (OMIM:181250):
- Postaxial polydactyly type A (HP:0005696): Supernumerary digits located at the ulnar side of the hand with a complete extra finger and extra metacarpal. Evidence: TAS. (OMIM:181250)
- Aplasia cutis congenita of scalp (HP:0007385): A developmental defect resulting in the congenital absence of skin on the scalp. Evidence: TAS. (OMIM:181250)
- Autosomal dominant inheritance (HP:0000006): A mode of inheritance that is observed for traits related to a gene encoded on one of the autosomes (i.e., the human chromosomes 1-22) in which a trait manifests in heterozygotes. In the context of medical genetics, an autosomal dominant disorder is caused when a single copy of the mutant allele is present. Males and females are affected equally, and can both transmit the disorder with a risk of 50% for each child of inheriting the mutant allele. Evidence: TAS. (OMIM:181250)